- Fatigue (HP:0012378): A subjective feeling of tiredness characterized by a lack of energy and motivation. Evidence: TAS. Frequency: Frequent (HP:0040282). (ORPHA:360)
- Abnormal nervous system physiology (HP:0012638): A functional anomaly of the nervous system. Evidence: TAS. Frequency: Frequent (HP:0040282). (ORPHA:360)
- Seizure (HP:0001250): A seizure is an intermittent abnormality of nervous system physiology characterized by a transient occurrence of signs and/or symptoms due to abnormal excessive or synchronous neuronal activity in the brain. Evidence: TAS. Frequency: Occasional (HP:0040283). (ORPHA:360)
- Memory impairment (HP:0002354): An impairment of memory as manifested by a reduced ability to remember things such as dates and names, and increased forgetfulness. Evidence: TAS. Frequency: Occasional (HP:0040283). (ORPHA:360)
- Glioblastoma multiforme (HP:0012174): A tumor arising from glia in the central nervous system with macroscopic regions of necrosis and hemorrhage. Microscopically, glioblastoma multiforme is characterized by regions of pseudopalisading necrosis, pleomorphic nuclei and cells, and microvascular proliferation. Evidence: TAS. Frequency: Obligate (HP:0040280). (ORPHA:360)
- Abnormal cell morphology (HP:0025461): Any anomaly of cell structure. Evidence: TAS. Frequency: Very frequent (HP:0040281). (ORPHA:360)
- Visual loss (HP:0000572): Loss of visual acuity (implying that vision was better at a certain time point in life). Otherwise the term reduced visual acuity should be used (or a subclass of that). Evidence: TAS. Frequency: Frequent (HP:0040282). (ORPHA:360)
- Emotional lability (HP:0000712): Unstable emotional experiences and frequent mood changes; emotions that are easily aroused, intense, and/or disproportionate to events and circumstances. Evidence: TAS. Frequency: Frequent (HP:0040282). (ORPHA:360)
- Abnormal corpus callosum morphology (HP:0001273): Abnormality of the corpus callosum. Evidence: TAS. Frequency: Frequent (HP:0040282). (ORPHA:360)
- Muscle weakness (HP:0001324): Reduced strength of muscles. Evidence: TAS. Frequency: Frequent (HP:0040282). (ORPHA:360)
- Cerebral edema (HP:0002181): Abnormal accumulation of fluid in the brain. Evidence: TAS. Frequency: Frequent (HP:0040282). (ORPHA:360)
- Headache (HP:0002315): Cephalgia, or pain sensed in various parts of the head, not confined to the area of distribution of any nerve. Evidence: TAS. Frequency: Frequent (HP:0040282). (ORPHA:360)
- Language impairment (HP:0002463): Language impairment is a deficit in comprehension or production of language that includes reduced vocabulary, limited sentence structure, or impairments in written or spoken communication. Language abilities are substantially and quantifiably below age expectations. Evidence: TAS. Frequency: Frequent (HP:0040282). (ORPHA:360)
- Abnormal cerebral white matter morphology (HP:0002500): An abnormality of the cerebral white matter. Evidence: TAS. Frequency: Frequent (HP:0040282). (ORPHA:360)
- Paralysis (HP:0003470): Paralysis of voluntary muscles means loss of contraction due to interruption of one or more motor pathways from the brain to the muscle fibers. Although the word paralysis is often used interchangeably to mean either complete or partial loss of muscle strength, it is preferable to use paralysis or plegia for complete or severe loss of muscle strength, and paresis for partial or slight loss. Motor paralysis results from deficits of the upper motor neurons (corticospinal, corticobulbar, or subcorticospinal). Motor paralysis is often accompanied by an impairment in the facility of movement. Evidence: TAS. Frequency: Frequent (HP:0040282). (ORPHA:360)
These phenotypes are associated with the disease Glioblastoma (ORPHA:360).